- Cleft palate (HP:0000175): Cleft palate is a developmental defect of the palate resulting from a failure of fusion of the palatine processes and manifesting as a separation of the roof of the mouth (soft and hard palate). Evidence: IEA. (OMIM:600252)
- Microcephaly (HP:0000252): Head circumference below 2 standard deviations below the mean for age and gender. Evidence: IEA. (OMIM:600252)
- Craniosynostosis (HP:0001363): Craniosynostosis refers to the premature closure of the cranial sutures. Primary craniosynostosis refers to the closure of one or more sutures due to abnormalities in skull development, and secondary craniosynostosis results from failure of brain growth. Evidence: IEA. (OMIM:600252)
- Preauricular pit (HP:0004467): Small indentation anterior to the insertion of the ear. Evidence: IEA. (OMIM:600252)
- Delayed eruption of teeth (HP:0000684): Delayed tooth eruption, which can be defined as tooth eruption more than 2 SD beyond the mean eruption age. Evidence: IEA. (OMIM:600252)
- Global developmental delay (HP:0001263): A delay in the achievement of motor or mental milestones in the domains of development of a child, including motor skills, speech and language, cognitive skills, and social and emotional skills. This term should only be used to describe children younger than five years of age. Evidence: IEA. (OMIM:600252)
- Diaphragmatic eventration (HP:0009110): A congenital failure of muscular development of part or all of one or both hemidiaphragms, resulting in superior displacement of abdominal viscera and altered lung development. Evidence: TAS. (OMIM:600252)
- Abnormal heart morphology (HP:0001627): Any structural anomaly of the heart. Evidence: TAS. (OMIM:600252)
- Convex nasal ridge (HP:0000444): Nasal ridge curving anteriorly to an imaginary line that connects the nasal root and tip. The nose appears often also prominent, and the columella low. Evidence: IEA. (OMIM:600252)
- Intrauterine growth retardation (HP:0001511): An abnormal restriction of fetal growth with fetal weight below the tenth percentile for gestational age. Evidence: IEA. (OMIM:600252)
- Glaucoma (HP:0000501): Glaucoma refers loss of retinal ganglion cells in a characteristic pattern of optic neuropathy usually associated with increased intraocular pressure. Evidence: IEA. (OMIM:600252)
- Intellectual disability (HP:0001249): The term intellectual disability or intellectual developmental disorder is used to describe significantly sub-average intellectual and adaptive functioning based on clinical assessment and as measured by individually administered, appropriately normed, standardized and validated tests of intellectual functioning and adaptive behavior, with onset during the developmental period from infancy through adolescence. Evidence: IEA. (OMIM:600252)
- Autosomal dominant inheritance (HP:0000006): A mode of inheritance that is observed for traits related to a gene encoded on one of the autosomes (i.e., the human chromosomes 1-22) in which a trait manifests in heterozygotes. In the context of medical genetics, an autosomal dominant disorder is caused when a single copy of the mutant allele is present. Males and females are affected equally, and can both transmit the disorder with a risk of 50% for each child of inheriting the mutant allele. Evidence: TAS. (OMIM:600252)
These phenotypes are associated with the disease Lowry-MacLean syndrome (OMIM:600252).